Phenotypes associated with the disease COG5-CDG (ORPHA:263487):
- Delayed speech and language development (HP:0000750): A degree of language development that is significantly below the norm for a child of a specified age. Evidence: TAS. Frequency: Very frequent (HP:0040281). (ORPHA:263487)
- Motor delay (HP:0001270): A type of Developmental delay characterized by a delay in acquiring motor skills. Evidence: TAS. Frequency: Very frequent (HP:0040281). (ORPHA:263487)
- Floppy infant (HP:0008947): Floppiness/hypotonia is defined as reduced resistance to passive movement of joints. Physical examination of floppy/hypotonic infants shows head lag, lack of shoulder and elbow muscle contraction on traction response, inability to tighten the shoulder girdle muscles (or slipping through) when held under the axillae, scarf sign (when the arm is pulled to the opposite side, the arm wraps around the neck with the elbow crossing midline), hyperdorsiflexion of the feet, easy apposition of the thumb against the forearm, feet touching the cheek with ease and without discomfort, frog leg position, and inverted U sign on ventral suspension (head, arms, and legs hanging down without elbow or knee flexion and the trunk rounded in a dome shape). Evidence: TAS. Frequency: Very frequent (HP:0040281). (ORPHA:263487)
- Microcephaly (HP:0000252): Head circumference below 2 standard deviations below the mean for age and gender. Evidence: TAS. Frequency: Frequent (HP:0040282). (ORPHA:263487)
- Posteriorly rotated ears (HP:0000358): A type of abnormal location of the ears in which the position of the ears is characterized by posterior rotation (the superior part of the ears is rotated towards the back of the head, and the inferior part of the ears towards the front). Evidence: TAS. Frequency: Frequent (HP:0040282). (ORPHA:263487)
- Low-set ears (HP:0000369): Upper insertion of the ear to the scalp below an imaginary horizontal line drawn between the inner canthi of the eye and extending posteriorly to the ear. Evidence: TAS. Frequency: Frequent (HP:0040282). (ORPHA:263487)
- Prominent nose (HP:0000448): Distance between subnasale and pronasale more than two standard deviations above the mean, or alternatively, an apparently increased anterior protrusion of the nasal tip. Evidence: TAS. Frequency: Frequent (HP:0040282). (ORPHA:263487)
- Short stature (HP:0004322): A height below that which is expected according to age and gender norms. Although there is no universally accepted definition of short stature, many refer to "short stature" as height more than 2 standard deviations below the mean for age and gender (or below the 3rd percentile for age and gender dependent norms). Evidence: TAS. Frequency: Frequent (HP:0040282). (ORPHA:263487)
- Severe intellectual disability (HP:0010864): Severe intellectual disability (ID) is defined as a type of ID characterized by severely sub-average adaptive functioning and intellectual functioning, with an intelligence quotient (IQ) the range of 20-34. Evidence: TAS. Frequency: Frequent (HP:0040282). (ORPHA:263487)
- Neurogenic bladder (HP:0000011): A type of bladder dysfunction caused by neurologic damage. Neurogenic bladder can be flaccid or spastic. Common manifestatios of neurogenic bladder are overflow incontinence, frequency, urgency, urge incontinence, and retention. Evidence: TAS. Frequency: Occasional (HP:0040283). (ORPHA:263487)
- Urinary incontinence (HP:0000020): Loss of the ability to control the urinary bladder leading to involuntary urination. Evidence: TAS. Frequency: Occasional (HP:0040283). (ORPHA:263487)
- Cryptorchidism (HP:0000028): Testis in inguinal canal. That is, absence of one or both testes from the scrotum owing to failure of the testis or testes to descend through the inguinal canal to the scrotum. Evidence: TAS. Frequency: Occasional (HP:0040283). (ORPHA:263487)
- Micropenis (HP:0000054): Abnormally small penis. At birth, the normal penis is about 3 cm (stretched length from pubic tubercle to tip of penis) with micropenis less than 2.0-2.5 cm. Evidence: TAS. Frequency: Occasional (HP:0040283). (ORPHA:263487)
- High palate (HP:0000218): Height of the palate more than 2 SD above the mean (objective) or palatal height at the level of the first permanent molar more than twice the height of the teeth (subjective). Evidence: TAS. Frequency: Occasional (HP:0040283). (ORPHA:263487)
- Retrognathia (HP:0000278): An abnormality in which the mandible is mislocalised posteriorly. Evidence: TAS. Frequency: Occasional (HP:0040283). (ORPHA:263487)
- Sensorineural hearing impairment (HP:0000407): A type of hearing impairment in one or both ears related to an abnormal functionality of the cochlear nerve. Evidence: TAS. Frequency: Occasional (HP:0040283). (ORPHA:263487)
- Wide nasal bridge (HP:0000431): Increased breadth of the nasal bridge (and with it, the nasal root). Evidence: TAS. Frequency: Occasional (HP:0040283). (ORPHA:263487)
- Short neck (HP:0000470): Diminished length of the neck. Evidence: TAS. Frequency: Occasional (HP:0040283). (ORPHA:263487)
- Strabismus (HP:0000486): A misalignment of the eyes so that the visual axes deviate from bifoveal fixation. The classification of strabismus may be based on a number of features including the relative position of the eyes, whether the deviation is latent or manifest, intermittent or constant, concomitant or otherwise and according to the age of onset and the relevance of any associated refractive error. Evidence: TAS. Frequency: Occasional (HP:0040283). (ORPHA:263487)
- Abnormality of the frontal hairline (HP:0000599): An anomaly in the placement or shape of the hairline (trichion) on the forehead, that is, the border between skin on the forehead that has head hair and that does not. Evidence: TAS. Frequency: Occasional (HP:0040283). (ORPHA:263487)
- Autistic behavior (HP:0000729): Persistent deficits in social interaction and communication and interaction as well as a markedly restricted repertoire of activity and interest as well as repetitive patterns of behavior. Evidence: TAS. Frequency: Occasional (HP:0040283). (ORPHA:263487)
- Seizure (HP:0001250): A seizure is an intermittent abnormality of nervous system physiology characterized by a transient occurrence of signs and/or symptoms due to abnormal excessive or synchronous neuronal activity in the brain. Evidence: TAS. Frequency: Occasional (HP:0040283). (ORPHA:263487)
- Mild intellectual disability (HP:0001256): Mild intellectual disability (ID) is defined as a type of ID characterized by mildly sub-average adaptive functioning and intellectual functioning, with an intelligence quotient (IQ) the range of 50-69. Evidence: TAS. Frequency: Occasional (HP:0040283). (ORPHA:263487)
- Cerebellar atrophy (HP:0001272): Cerebellar atrophy is defined as a cerebellum with initially normal structures, in a posterior fossa with normal size, which displays enlarged fissures (interfolial spaces) in comparison to the foliae secondary to loss of tissue. Cerebellar atrophy implies irreversible loss of tissue and result from an ongoing progressive disease until a final stage is reached or a single injury, e.g. an intoxication or infectious event. Evidence: TAS. Frequency: Occasional (HP:0040283). (ORPHA:263487)
- Brisk reflexes (HP:0001348): Tendon reflexes that are noticeably more active than usual (conventionally denoted 3+ on clinical examination). Brisk reflexes may or may not indicate a neurological lesion. They are distinguished from hyperreflexia by the fact that hyerreflexia is characterized by hyperactive repeating (clonic) reflexes, which are considered to be always abnormal. Evidence: TAS. Frequency: Occasional (HP:0040283). (ORPHA:263487)
- Hepatosplenomegaly (HP:0001433): Simultaneous enlargement of the liver and spleen. Evidence: TAS. Frequency: Occasional (HP:0040283). (ORPHA:263487)
- Intrauterine growth retardation (HP:0001511): An abnormal restriction of fetal growth with fetal weight below the tenth percentile for gestational age. Evidence: TAS. Frequency: Occasional (HP:0040283). (ORPHA:263487)
- Oligohydramnios (HP:0001562): Diminished amniotic fluid volume in pregnancy. Evidence: TAS. Frequency: Occasional (HP:0040283). (ORPHA:263487)
- Truncal ataxia (HP:0002078): Truncal ataxia is a sign of ataxia characterized by instability of the trunk. It usually occurs during sitting. Evidence: TAS. Frequency: Occasional (HP:0040283). (ORPHA:263487)
- Hepatomegaly (HP:0002240): Abnormally increased size of the liver. Evidence: TAS. Frequency: Occasional (HP:0040283). (ORPHA:263487)
- Moderate intellectual disability (HP:0002342): Moderate intellectual disability (ID) is defined as a type of ID characterized by moderately sub-average adaptive functioning and intellectual functioning, with an intelligence quotient (IQ) the range of 35-49. Evidence: TAS. Frequency: Occasional (HP:0040283). (ORPHA:263487)
- Diffuse cerebral atrophy (HP:0002506): Diffuse unlocalised atrophy affecting the cerebrum. Evidence: TAS. Frequency: Occasional (HP:0040283). (ORPHA:263487)
- Genu valgum (HP:0002857): The legs angle inward, such that the knees are close together and the ankles far apart. Evidence: TAS. Frequency: Occasional (HP:0040283). (ORPHA:263487)
- Elevated circulating hepatic transaminase concentration (HP:0002910): Elevations of the levels of SGOT and SGPT in the serum. SGOT (serum glutamic oxaloacetic transaminase) and SGPT (serum glutamic pyruvic transaminase) are transaminases primarily found in the liver and heart and are released into the bloodstream as the result of liver or heart damage. SGOT and SGPT are used clinically mainly as markers of liver damage. Evidence: TAS. Frequency: Occasional (HP:0040283). (ORPHA:263487)
- Abnormal isoelectric focusing of serum transferrin (HP:0003160): Glycosylated transferrin concentrations can be measured in serum as a marker of N-linked glycosylation fidelity. In the traditional nomenclature for congenital disorders of glycosylation, absence of entire glycans was designated type I, and loss of one or more monosaccharides as type II. These terms are retained for historical reasons but for new annotations the precise glycosylation defect should be recorded. Evidence: TAS. Frequency: Occasional (HP:0040283). (ORPHA:263487)
- Lateral ventricle dilatation (HP:0006956). Evidence: TAS. Frequency: Occasional (HP:0040283). (ORPHA:263487)
- Atrophy/Degeneration affecting the brainstem (HP:0007366). Evidence: TAS. Frequency: Occasional (HP:0040283). (ORPHA:263487)
- Joint contracture of the hand (HP:0009473): Contractures of one ore more joints of the hands meaning chronic loss of joint motion due to structural changes in non-bony tissue. Evidence: TAS. Frequency: Occasional (HP:0040283). (ORPHA:263487)
- Gastrostomy tube feeding in infancy (HP:0011471): Feeding problem necessitating gastrostomy tube feeding. Evidence: TAS. Frequency: Occasional (HP:0040283). (ORPHA:263487)
- Brain atrophy (HP:0012444): Partial or complete wasting (loss) of brain tissue that was once present. Evidence: TAS. Frequency: Occasional (HP:0040283). (ORPHA:263487)
- Delayed myelination (HP:0012448): Delayed myelination. Evidence: TAS. Frequency: Occasional (HP:0040283). (ORPHA:263487)
- Cerebral white matter atrophy (HP:0012762): The presence of atrophy (wasting) of the cerebral white matter. Evidence: TAS. Frequency: Occasional (HP:0040283). (ORPHA:263487)
- Finger clinodactyly (HP:0040019). Evidence: TAS. Frequency: Occasional (HP:0040283). (ORPHA:263487)
- Camptodactyly of finger (HP:0100490): The distal interphalangeal joint and/or the proximal interphalangeal joint of the fingers cannot be extended to 180 degrees by either active or passive extension. Evidence: TAS. Frequency: Occasional (HP:0040283). (ORPHA:263487)
- Premature skin wrinkling (HP:0100678): The presence of an increased degree of wrinkling (irregular folds and indentations) of the skin as compared with age-related norms. Evidence: TAS. Frequency: Occasional (HP:0040283). (ORPHA:263487)
- Cerebral visual impairment (HP:0100704): A form of loss of vision caused by damage to the visual cortex rather than a defect in the eye. Evidence: TAS. Frequency: Occasional (HP:0040283). (ORPHA:263487)